- Congenital onset (HP:0003577): A phenotypic abnormality that is present at birth. Evidence: PCS. Frequency: 2/2. (PMID:20631719)
- Secundum atrial septal defect (HP:0001684): A kind of atrial septum defect arising from an enlarged foramen ovale, inadequate growth of the septum secundum, or excessive absorption of the septum primum. Evidence: PCS. Frequency: 2/4. (PMID:20631719)
- Bicuspid aortic valve (HP:0001647): The presence of an aortic valve with two instead of the normal three cusps (flaps). Bicuspid aortic valvue is a malformation of a commissure (small space between the attachment of each cusp to the aortic wall) and the adjacent parts of the two corresponding cusps forming a raphe (the fused area of the two underdeveloped cusps turning into a malformed commissure between both cusps; the raphe is a fibrous ridge that extends from the commissure to the free edge of the two underdeveloped, conjoint cusps). Evidence: PCS. Frequency: 1/4. (PMID:20631719)
- Pulmonary arterial hypertension (HP:0002092): Pulmonary hypertension is defined mean pulmonary artery pressure of 25mmHg or more and pulmonary capillary wedge pressure of 15mmHg or less when measured by right heart catheterisation at rest and in a supine position. Evidence: PCS. Frequency: 1/4. (PMID:20631719)
- Autosomal dominant inheritance (HP:0000006): A mode of inheritance that is observed for traits related to a gene encoded on one of the autosomes (i.e., the human chromosomes 1-22) in which a trait manifests in heterozygotes. In the context of medical genetics, an autosomal dominant disorder is caused when a single copy of the mutant allele is present. Males and females are affected equally, and can both transmit the disorder with a risk of 50% for each child of inheriting the mutant allele. Evidence: PCS. (PMID:20631719)
These phenotypes are associated with the disease atrial septal defect 9 (OMIM:614475).